Phenotypes associated with the disease Fumaric aciduria (ORPHA:24):
- Decreased fumarate hydratase activity (HP:0003536): An abnormality of Krebs cycle metabolism that is characterized by a decreased rate of fumarate hydratase activity. Evidence: TAS. Frequency: Very frequent (HP:0040281). (ORPHA:24)
- Hypertelorism (HP:0000316): Interpupillary distance more than 2 SD above the mean (alternatively, the appearance of an increased interpupillary distance or widely spaced eyes). Evidence: TAS. Frequency: Frequent (HP:0040282). (ORPHA:24)
- Seizure (HP:0001250): A seizure is an intermittent abnormality of nervous system physiology characterized by a transient occurrence of signs and/or symptoms due to abnormal excessive or synchronous neuronal activity in the brain. Evidence: TAS. Frequency: Frequent (HP:0040282). (ORPHA:24)
- Hypotonia (HP:0001252): Hypotonia is an abnormally low muscle tone (the amount of tension or resistance to movement in a muscle). Even when relaxed, muscles have a continuous and passive partial contraction which provides some resistance to passive stretching. Hypotonia thus manifests as diminished resistance to passive stretching. Hypotonia is not the same as muscle weakness, although the two conditions can co-exist. Evidence: TAS. Frequency: Frequent (HP:0040282). (ORPHA:24)
- Lethargy (HP:0001254): A state of fatigue, either physical or mental slowness and sluggishness, with difficulties in initiating or performing simple tasks. Distinguished from apathy which implies indifference and a lack of desire or interest in the task. A person with lethargy may have the desire, but not the energy to engage in personal or socially relevant tasks. Evidence: TAS. Frequency: Frequent (HP:0040282). (ORPHA:24)
- Global developmental delay (HP:0001263): A delay in the achievement of motor or mental milestones in the domains of development of a child, including motor skills, speech and language, cognitive skills, and social and emotional skills. This term should only be used to describe children younger than five years of age. Evidence: TAS. Frequency: Frequent (HP:0040282). (ORPHA:24)
- Encephalopathy (HP:0001298): Encephalopathy is a term that means brain disease, damage, or malfunction. In general, encephalopathy is manifested by an altered mental state. Evidence: TAS. Frequency: Frequent (HP:0040282). (ORPHA:24)
- Failure to thrive in infancy (HP:0001531). Evidence: TAS. Frequency: Frequent (HP:0040282). (ORPHA:24)
- Polyhydramnios (HP:0001561): The presence of excess amniotic fluid in the uterus during pregnancy. Evidence: TAS. Frequency: Frequent (HP:0040282). (ORPHA:24)
- Premature birth (HP:0001622): The birth of a baby of less than 37 weeks of gestational age. Evidence: TAS. Frequency: Frequent (HP:0040282). (ORPHA:24)
- Frontal bossing (HP:0002007): Bilateral bulging of the lateral frontal bone prominences with relative sparing of the midline. Evidence: TAS. Frequency: Frequent (HP:0040282). (ORPHA:24)
- Cerebral atrophy (HP:0002059): Atrophy (wasting, decrease in size of cells or tissue) affecting the cerebrum. Evidence: TAS. Frequency: Frequent (HP:0040282). (ORPHA:24)
- Ventriculomegaly (HP:0002119): An increase in size of the ventricular system of the brain. Evidence: TAS. Frequency: Frequent (HP:0040282). (ORPHA:24)
- Depressed nasal bridge (HP:0005280): Posterior positioning of the nasal root in relation to the overall facial profile for age. Evidence: TAS. Frequency: Frequent (HP:0040282). (ORPHA:24)
- Feeding difficulties in infancy (HP:0008872): Impaired feeding performance of an infant as manifested by difficulties such as weak and ineffective sucking, brief bursts of sucking, and falling asleep during sucking. There may be difficulties with chewing or maintaining attention. Evidence: TAS. Frequency: Frequent (HP:0040282). (ORPHA:24)
- Microcephaly (HP:0000252): Head circumference below 2 standard deviations below the mean for age and gender. Evidence: TAS. Frequency: Occasional (HP:0040283). (ORPHA:24)
- Anteverted nares (HP:0000463): Anteriorly-facing nostrils viewed with the head in the Frankfurt horizontal and the eyes of the observer level with the eyes of the subject. This gives the appearance of an upturned nose (upturned nasal tip). Evidence: TAS. Frequency: Occasional (HP:0040283). (ORPHA:24)
- Optic atrophy (HP:0000648): Atrophy of the optic nerve. Optic atrophy results from the death of the retinal ganglion cell axons that comprise the optic nerve and manifesting as a pale optic nerve on fundoscopy. Evidence: TAS. Frequency: Occasional (HP:0040283). (ORPHA:24)
- Reduced eye contact (HP:0000817): A reduced frequency or duration of eye contact. Evidence: TAS. Frequency: Occasional (HP:0040283). (ORPHA:24)
- Coma (HP:0001259): The complete absence of wakefulness and consciousness, which is evident through a lack of response to any form of external stimuli. Evidence: TAS. Frequency: Occasional (HP:0040283). (ORPHA:24)
- Abnormal corpus callosum morphology (HP:0001273): Abnormality of the corpus callosum. Evidence: TAS. Frequency: Occasional (HP:0040283). (ORPHA:24)
- Dystonia (HP:0001332): An abnormally increased muscular tone that causes fixed abnormal postures. There is a slow, intermittent twisting motion that leads to exaggerated turning and posture of the extremities and trunk. Evidence: TAS. Frequency: Occasional (HP:0040283). (ORPHA:24)
- Intrauterine growth retardation (HP:0001511): An abnormal restriction of fetal growth with fetal weight below the tenth percentile for gestational age. Evidence: TAS. Frequency: Occasional (HP:0040283). (ORPHA:24)
- Oligohydramnios (HP:0001562): Diminished amniotic fluid volume in pregnancy. Evidence: TAS. Frequency: Occasional (HP:0040283). (ORPHA:24)
- Decreased total neutrophil count (HP:0001875): Abnormal decrease of absolute number of neutrophils in the blood, per microlitre, compared to a reference range for a given sex and age-group. Evidence: TAS. Frequency: Occasional (HP:0040283). (ORPHA:24)
- Polycythemia (HP:0001901): Polycythemia is diagnosed if the red blood cell count, the hemoglobin level, and the red blood cell volume all exceed the upper limits of normal. Evidence: TAS. Frequency: Occasional (HP:0040283). (ORPHA:24)
- Vomiting (HP:0002013): Forceful ejection of the contents of the stomach through the mouth by means of a series of involuntary spasmic contractions. Evidence: TAS. Frequency: Occasional (HP:0040283). (ORPHA:24)
- Hepatomegaly (HP:0002240): Abnormally increased size of the liver. Evidence: TAS. Frequency: Occasional (HP:0040283). (ORPHA:24)
- Poor head control (HP:0002421): Difficulty to maintain correct position of the head while standing or sitting. Infant head lag is observed when the head seems to flop around or lags posteriorly behind the trunk. Several articles have maintained that head lag should be absent by age 3 to 4 months. Evidence: TAS. Frequency: Occasional (HP:0040283). (ORPHA:24)
- Abnormal cerebral white matter morphology (HP:0002500): An abnormality of the cerebral white matter. Evidence: TAS. Frequency: Occasional (HP:0040283). (ORPHA:24)
- Hypsarrhythmia (HP:0002521): Hypsarrhythmia is abnormal interictal high amplitude waves and a background of irregular spikes. There is continuous (during wakefulness), high-amplitude (>200 Hz), generalized polymorphic slowing with no organized background and multifocal spikes demonstrated by electroencephalography (EEG). Evidence: TAS. Frequency: Occasional (HP:0040283). (ORPHA:24)
- Cleft ala nasi (HP:0003191): The presence of a notch in the margin of the ala nasi. Evidence: TAS. Frequency: Occasional (HP:0040283). (ORPHA:24)
- Cerebral hypomyelination (HP:0006808): Reduced amount of myelin in the nervous system resulting from defective myelinogenesis in the white matter of the central nervous system. Evidence: TAS. Frequency: Occasional (HP:0040283). (ORPHA:24)
- Tented upper lip vermilion (HP:0010804): Triangular appearance of the oral aperture with the apex in the midpoint of the upper vermilion and the lower vermilion forming the base. Evidence: TAS. Frequency: Occasional (HP:0040283). (ORPHA:24)
- Increased urine alpha-ketoglutarate concentration (HP:0012402): A greater than normal concentration of 2-oxoglutaric acid in the urine. Evidence: TAS. Frequency: Occasional (HP:0040283). (ORPHA:24)
- Delayed myelination (HP:0012448): Delayed myelination. Evidence: TAS. Frequency: Occasional (HP:0040283). (ORPHA:24)
- Infantile spasms (HP:0012469): Infantile spasms represent a subset of "epileptic spasms". Infantile Spasms are epileptic spasms starting in the first year of life (infancy). Evidence: TAS. Frequency: Occasional (HP:0040283). (ORPHA:24)
- Bilateral polymicrogyria (HP:0025646): Polymicrogyria that affects all or some of both cerebral hemispheres. Evidence: TAS. Frequency: Occasional (HP:0040283). (ORPHA:24)
- Elevated urine fumaric acid level (HP:0034648): The concentration of fumaric acid in the urine, normalized for urine concentration, is above the upper limit of normal. Evidence: TAS. Frequency: Occasional (HP:0040283). (ORPHA:24)
- Cerebral visual impairment (HP:0100704): A form of loss of vision caused by damage to the visual cortex rather than a defect in the eye. Evidence: TAS. Frequency: Occasional (HP:0040283). (ORPHA:24)
- Metabolic acidosis (HP:0001942): Metabolic acidosis (MA) is characterized by a fall in blood pH due to a reduction of serum bicarbonate concentration. This can occur as a result of either the accumulation of acids (high anion gap MA) or the loss of bicarbonate from the gastrointestinal tract or the kidney (hyperchloremic MA). By definition, MA is not due to a respirary cause. Evidence: TAS. Frequency: Very rare (HP:0040284). (ORPHA:24)
- Hypoglycemia (HP:0001943): A decreased concentration of glucose in the blood. Evidence: TAS. Frequency: Very rare (HP:0040284). (ORPHA:24)
- Hyperammonemia (HP:0001987): An increased concentration of ammonia in the blood. Evidence: TAS. Frequency: Very rare (HP:0040284). (ORPHA:24)
- Lactic acidosis (HP:0003128): An abnormal buildup of lactic acid in the body, leading to acidification of the blood and other bodily fluids. Evidence: TAS. Frequency: Very rare (HP:0040284). (ORPHA:24)